- Euthyroid hyperthyroxinemia (HP:0008247): Increased levels of thyroxine without evidence of clinical thyroid disease. Evidence: TAS. (OMIM:188560)
- Autosomal dominant inheritance (HP:0000006): A mode of inheritance that is observed for traits related to a gene encoded on one of the autosomes (i.e., the human chromosomes 1-22) in which a trait manifests in heterozygotes. In the context of medical genetics, an autosomal dominant disorder is caused when a single copy of the mutant allele is present. Males and females are affected equally, and can both transmit the disorder with a risk of 50% for each child of inheriting the mutant allele. Evidence: TAS. (OMIM:188560)
- Goiter (HP:0000853): An enlargement of the thyroid gland. Evidence: TAS. (OMIM:188560)
These phenotypes are associated with the disease thyroid hormone plasma membrane transport defect (OMIM:188560).